Phenotypes associated with the disease developmental and epileptic encephalopathy, 27 (OMIM:616139):
- Bilateral tonic-clonic seizure (HP:0002069): A bilateral tonic-clonic seizure is a seizure defined by a tonic (bilateral increased tone, lasting seconds to minutes) and then a clonic (bilateral sustained rhythmic jerking) phase. Evidence: PCS. Frequency: 1/2. (PMID:24272827)
- Axial hypotonia (HP:0008936): Muscular hypotonia (abnormally low muscle tone) affecting the musculature of the trunk. Evidence: PCS. Frequency: 1/2. (PMID:24272827)
- Microcephaly (HP:0000252): Head circumference below 2 standard deviations below the mean for age and gender. Evidence: IEA. Frequency: Very rare (HP:0040284). (OMIM:616139)
- Hypsarrhythmia (HP:0002521): Hypsarrhythmia is abnormal interictal high amplitude waves and a background of irregular spikes. There is continuous (during wakefulness), high-amplitude (>200 Hz), generalized polymorphic slowing with no organized background and multifocal spikes demonstrated by electroencephalography (EEG). Evidence: PCS. Frequency: 2/2. (PMID:24272827)
- Absent speech (HP:0001344): Complete lack of development of speech and language abilities. Evidence: PCS. Frequency: 2/2. (PMID:24272827)
- Dystonia (HP:0001332): An abnormally increased muscular tone that causes fixed abnormal postures. There is a slow, intermittent twisting motion that leads to exaggerated turning and posture of the extremities and trunk. Evidence: PCS. Frequency: 1/2. (PMID:24272827)
- Seizure (HP:0001250): A seizure is an intermittent abnormality of nervous system physiology characterized by a transient occurrence of signs and/or symptoms due to abnormal excessive or synchronous neuronal activity in the brain. Evidence: TAS. (OMIM:616139)
- Feeding difficulties (HP:0011968): Impaired ability to eat related to problems gathering food and getting ready to suck, chew, or swallow it. Evidence: PCS. Frequency: 1/2. (PMID:24272827)
- Hypotonia (HP:0001252): Hypotonia is an abnormally low muscle tone (the amount of tension or resistance to movement in a muscle). Even when relaxed, muscles have a continuous and passive partial contraction which provides some resistance to passive stretching. Hypotonia thus manifests as diminished resistance to passive stretching. Hypotonia is not the same as muscle weakness, although the two conditions can co-exist. Evidence: PCS. Frequency: 1/2. (PMID:24272827)
- Global developmental delay (HP:0001263): A delay in the achievement of motor or mental milestones in the domains of development of a child, including motor skills, speech and language, cognitive skills, and social and emotional skills. This term should only be used to describe children younger than five years of age. Evidence: PCS. Frequency: 2/2. (PMID:24272827)
- Infantile onset (HP:0003593): Onset of signs or symptoms of disease between 28 days to one year of life. Evidence: PCS. Frequency: 2/2. (PMID:24272827)
- Myoclonic seizure (HP:0032794): A myoclonic seizure is a type of motor seizure characterized by sudden, brief (<100 ms) involuntary single or multiple contraction of muscles or muscle groups of variable topography (axial, proximal limb, distal). Myoclonus is less regularly repetitive and less sustained than is clonus. Evidence: PCS. Frequency: 1/2. (PMID:24272827)
- Chorea (HP:0002072): Chorea (Greek for 'dance') refers to widespread arrhythmic involuntary movements of a forcible, jerky and restless fashion. It is a random-appearing sequence of one or more discrete involuntary movements or movement fragments. Movements appear random because of variability in timing, duration or location. Each movement may have a distinct start and end. However, movements may be strung together and thus may appear to flow randomly from one muscle group to another. Chorea can involve the trunk, neck, face, tongue, and extremities. Evidence: IEA. (OMIM:616139)
- Mild microcephaly (HP:0040196): Decreased occipito-frontal (head) circumference (OFC). For the microcephaly OFC must be between -3 SD and -2 SD compared to appropriate, age matched, normal standards (i.e. -3 SD <= OFC < -2 SD). Evidence: PCS. Frequency: 1/2. (PMID:24272827)
- Dyskinesia (HP:0100660): A movement disorder which consists of effects including diminished voluntary movements and the presence of involuntary movements. Evidence: IEA. (OMIM:616139)
- Infantile spasms (HP:0012469): Infantile spasms represent a subset of "epileptic spasms". Infantile Spasms are epileptic spasms starting in the first year of life (infancy). Evidence: PCS. Frequency: 2/2. (PMID:24272827)
- Epileptic spasm (HP:0011097): A sudden flexion, extension, or mixed extension-flexion of predominantly proximal and truncal muscles that is usually more sustained than a myoclonic movement but not as sustained as a tonic seizure. Limited forms may occur: Grimacing, head nodding, or subtle eye movements. Epileptic spasms frequently occur in clusters. Infantile spasms are the best known form, but spasms can occur at all ages. Evidence: PCS. Frequency: 1/2. (PMID:24272827)
- Reduced eye contact (HP:0000817): A reduced frequency or duration of eye contact. Evidence: PCS. Frequency: 1/2. (PMID:24272827)
- Epileptic encephalopathy (HP:0200134): A condition in which epileptiform abnormalities are believed to contribute to the progressive disturbance in cerebral function. Epileptic encephalaopathy is characterized by (1) electrographic EEG paroxysmal activity that is often aggressive, (2) seizures that are usually multiform and intractable, (3) cognitive, behavioral and neurological deficits that may be relentless, and (4) sometimes early death. Evidence: PCS. (PMID:24272827)
- Delayed ability to sit (HP:0025336): A failure to achieve the ability to sit at an appropriate developmental stage. Most children sit with support at 6 months of age and sit steadily without support at 9 months of age. Evidence: PCS. Frequency: 2/2. (PMID:24272827)
- Spasticity (HP:0001257): A motor disorder characterized by a velocity-dependent increase in tonic stretch reflexes with increased muscle tone, exaggerated (hyperexcitable) tendon reflexes. Evidence: IEA. (OMIM:616139)
- Intellectual disability (HP:0001249): The term intellectual disability or intellectual developmental disorder is used to describe significantly sub-average intellectual and adaptive functioning based on clinical assessment and as measured by individually administered, appropriately normed, standardized and validated tests of intellectual functioning and adaptive behavior, with onset during the developmental period from infancy through adolescence. Evidence: TAS. (OMIM:616139)
- Autosomal dominant inheritance (HP:0000006): A mode of inheritance that is observed for traits related to a gene encoded on one of the autosomes (i.e., the human chromosomes 1-22) in which a trait manifests in heterozygotes. In the context of medical genetics, an autosomal dominant disorder is caused when a single copy of the mutant allele is present. Males and females are affected equally, and can both transmit the disorder with a risk of 50% for each child of inheriting the mutant allele. Evidence: PCS. (PMID:24272827)
- Myoclonus (HP:0001336): Very brief, involuntary random muscular contractions occurring at rest, in response to sensory stimuli, or accompanying voluntary movements. Evidence: PCS. Frequency: 1/2. (PMID:24272827)